Phenotypes associated with the disease tardive dyskinesia (OMIM:272620):
- Autosomal recessive inheritance (HP:0000007): A mode of inheritance that is observed for traits related to a gene encoded on one of the autosomes (i.e., the human chromosomes 1-22) in which a trait manifests in individuals with two pathogenic alleles, either homozygotes (two copies of the same mutant allele) or compound heterozygotes (whereby each copy of a gene has a distinct mutant allele). Evidence: IEA. (OMIM:272620)
- Tardive dyskinesia (HP:0040141). Evidence: TAS. (OMIM:272620)
- Akathisia (HP:0031943): A state of motor restlessness, usually in the lower extremities, that is often but not always accompanied by a subjective sense of inner restlessness, an urge to move, and anxiety or dysphoria. Evidence: IEA. (OMIM:272620)